- Confusion (HP:0001289): Lack of clarity and coherence of thought, perception, understanding, or action. Evidence: TAS. Frequency: Very frequent (HP:0040281). (ORPHA:33543)
- Amplification of sexual behavior (HP:5200321): An abnormal increase of libido (sexual desire), typically accompanied by a higher frequency of sexual activity compared to from a person's previous norm. Evidence: TAS. Frequency: Frequent (HP:0040282). (ORPHA:33543)
- Episodic hypersomnia (HP:0007200): Recurrent episodes of hypersomnia (sleeping 16 or more hours a day) over a period of days or weeks. Evidence: TAS. Frequency: Very frequent (HP:0040281). (ORPHA:33543)
- Cognitive impairment (HP:0100543): Abnormal cognition is characterized by deficits in thinking, reasoning, or remembering. Evidence: TAS. Frequency: Very frequent (HP:0040281). (ORPHA:33543)
- Photophobia (HP:0000613): Excessive sensitivity to light with the sensation of discomfort or pain in the eyes due to exposure to bright light. Evidence: TAS. Frequency: Frequent (HP:0040282). (ORPHA:33543)
- Agitation (HP:0000713): A state of excessive motor activity that is associated with mental distress or a feeling of substantial unease or inner tension. Distinguished from restlessness by the increased level of emotional distress and negative intensity of the experience. Agitation has a significant level of physical activity that is typically threatening to the self or others. Evidence: TAS. Frequency: Frequent (HP:0040282). (ORPHA:33543)
- Depression (HP:0000716): Frequently experiencing feelings of being down, miserable, and/or hopeless; struggling to recover from these moods; having a pessimistic outlook on the future; feeling a pervasive sense of shame; having a low self-worth; experiencing thoughts of suicide and engaging in suicidal behavior. Evidence: TAS. Frequency: Frequent (HP:0040282). (ORPHA:33543)
- Irritability (HP:0000737): An emotional state characterized by negative feelings of heightened frustration, annoyance, or feeling upset, often triggered by internal factors (e.g., fatigue, hunger, unfulfilled desires) or external factors (e.g., social or environmental challenges). Irritability may be unpredictable, and is accompanied by a lowered threshold for emotional reactivity and observable features (speech, facial expressions, or psychomotor activity). Evidence: TAS. Frequency: Frequent (HP:0040282). (ORPHA:33543)
- Anxiety (HP:0000739): Intense feelings of nervousness, tension, or panic often arise in response to interpersonal stresses. There is worry about the negative effects of past unpleasant experiences and future negative possibilities. Individuals may feel fearful, apprehensive, or threatened by uncertainty, and they may also have fears of falling apart or losing control. Evidence: TAS. Frequency: Frequent (HP:0040282). (ORPHA:33543)
- Apathy (HP:0000741): Apathy is a quantitative reduction of interest, motivation and the initiation and persistence of goal-directed behavior, where often the accompanying emotions, thoughts, and social interactions are also diminished. The individual is typically non-reactive to provocations, positive or negative, and appears to not care. Distinguished from lethargy which involves lack of physical or mental energy. Evidence: TAS. Frequency: Frequent (HP:0040282). (ORPHA:33543)
- Hyperhidrosis (HP:0000975): Abnormal excessive perspiration (sweating) despite the lack of appropriate stimuli like hot and humid weather. Evidence: TAS. Frequency: Frequent (HP:0040282). (ORPHA:33543)
- Fever (HP:0001945): Body temperature elevated above the normal range. Evidence: TAS. Frequency: Frequent (HP:0040282). (ORPHA:33543)
- Abnormal speech pattern (HP:0002167): An abnormality in the sound (volume) or cadence (rate) of speech. Evidence: TAS. Frequency: Frequent (HP:0040282). (ORPHA:33543)
- Headache (HP:0002315): Cephalgia, or pain sensed in various parts of the head, not confined to the area of distribution of any nerve. Evidence: TAS. Frequency: Frequent (HP:0040282). (ORPHA:33543)
- Polyphagia (HP:0002591): A neurological anomaly with gross overeating associated with an abnormally strong desire or need to eat. Evidence: TAS. Frequency: Frequent (HP:0040282). (ORPHA:33543)
- Poor hand-eye coordination (HP:0007057). Evidence: TAS. Frequency: Frequent (HP:0040282). (ORPHA:33543)
- Repetitive compulsive behavior (HP:0008762). Evidence: TAS. Frequency: Frequent (HP:0040282). (ORPHA:33543)
- Transient global amnesia (HP:0010534): A paroxysmal, transient loss of memory function with preservation of immediate recall and remote memory but with a severe impairment of memory for recent events and ability to retain new information. Evidence: TAS. Frequency: Frequent (HP:0040282). (ORPHA:33543)
- Abnormal brain FDG positron emission tomography (HP:0012658): An anomaly detectable in [18F]-fluorodeoxyglucose (FDG) positron emission tomography (PET) brain scans. Glucose uptake measured with FDG-PET is a marker of neuronal metabolic activity. Evidence: TAS. Frequency: Frequent (HP:0040282). (ORPHA:33543)
- Parageusia (HP:0031249): A distortion of the sense of taste, often characterized by the sensation of a metallic taste. Evidence: TAS. Frequency: Frequent (HP:0040282). (ORPHA:33543)
- Parosmia (HP:0034004): Misperception of existing odor, that is, distorted or altered olfactory perception in the presence of known stimuli. Evidence: TAS. Frequency: Frequent (HP:0040282). (ORPHA:33543)
- Abnormal eating behavior (HP:0100738): Abnormal eating habits involve excessive or insufficient consumption of food, or any other abnormal pattern of food consumption. Evidence: TAS. Frequency: Frequent (HP:0040282). (ORPHA:33543)
- Blurred vision (HP:0000622): Lack of sharpness of vision resulting in the inability to see fine detail. Evidence: TAS. Frequency: Occasional (HP:0040283). (ORPHA:33543)
- Delusion (HP:0000746): A delusion is a fixed false belief held despite evidence to the contrary. The term delusion broadly encompasses all false judgments that possess the following external characteristics to a significant, albeit unspecified, extent: (1) they are held with an exceptional level of conviction, accompanied by an unparalleled subjective certainty; (2) there is an inability to consider alternative experiences or compelling counter-arguments; (3) the content of the belief is impossible. Evidence: TAS. Frequency: Occasional (HP:0040283). (ORPHA:33543)
- Slurred speech (HP:0001350): Abnormal coordination of muscles involved in speech. Evidence: TAS. Frequency: Occasional (HP:0040283). (ORPHA:33543)
- Polydipsia (HP:0001959): Excessive thirst manifested by excessive fluid intake. Evidence: TAS. Frequency: Occasional (HP:0040283). (ORPHA:33543)
- Nausea (HP:0002018): A sensation of unease in the stomach together with an urge to vomit. Evidence: TAS. Frequency: Occasional (HP:0040283). (ORPHA:33543)
- Mutism (HP:0002300): Complete lack of speech or verbal communication in a person despite attempts to engage in conversation. Mutism as a phenomena assumes the individual has previous capacity for speech and in the pediatric population it assumes that the person is past the age of typical language development. Evidence: TAS. Frequency: Occasional (HP:0040283). (ORPHA:33543)
- Hypnagogic hallucination (HP:0002519): Hypnagogic hallucinations are brief hallucinations that occur when falling asleep. Evidence: TAS. Frequency: Occasional (HP:0040283). (ORPHA:33543)
- Poor appetite (HP:0004396): A reduced desire to eat. Evidence: TAS. Frequency: Occasional (HP:0040283). (ORPHA:33543)
- Sleep paralysis (HP:0025233): Inability to move trunk and limbs and inability to speak during transition into or out of sleep; awareness is preserved and recall is present. Evidence: TAS. Frequency: Occasional (HP:0040283). (ORPHA:33543)
- Sweet craving (HP:0030221): Excessive desire to eat sweet foods. Evidence: TAS. Frequency: Occasional (HP:0040283). (ORPHA:33543)
- Hot flashes (HP:0031217): Sudden feelings of warmth that are generally most pronounced over the face, neck and chest. Evidence: TAS. Frequency: Occasional (HP:0040283). (ORPHA:33543)
- Decreased libido (HP:0046504): Decreased sexual desire. Evidence: TAS. Frequency: Occasional (HP:0040283). (ORPHA:33543)
- Derealization (HP:5200218): A subjective experience in which an individual feels a sense of detachment or estrangement from their surroundings, leading to a distorted perception of the external world. It is characterized by a feeling of unreality or unfamiliarity with one's environment, as if things are dreamlike, artificial, or lacking in significance. Evidence: TAS. Frequency: Occasional (HP:0040283). (ORPHA:33543)
These phenotypes are associated with the disease Kleine-Levin syndrome (ORPHA:33543).